- Cataract (HP:0000518): A cataract is an opacity or clouding that develops in the crystalline lens of the eye or in its capsule. Evidence: IEA. (OMIM:609376)
- Autosomal recessive inheritance (HP:0000007): A mode of inheritance that is observed for traits related to a gene encoded on one of the autosomes (i.e., the human chromosomes 1-22) in which a trait manifests in individuals with two pathogenic alleles, either homozygotes (two copies of the same mutant allele) or compound heterozygotes (whereby each copy of a gene has a distinct mutant allele). Evidence: TAS. (OMIM:609376)
These phenotypes are associated with the disease cataract 35 (OMIM:609376).